Phenotypes associated with the disease MMEP syndrome (ORPHA:3434):
- Cryptorchidism (HP:0000028): Testis in inguinal canal. That is, absence of one or both testes from the scrotum owing to failure of the testis or testes to descend through the inguinal canal to the scrotum. Evidence: TAS. Frequency: Frequent (HP:0040282). (ORPHA:3434)
- Median cleft upper lip (HP:0000161): A type of cleft lip presenting as a midline (median) gap in the upper lip. Evidence: TAS. Frequency: Very frequent (HP:0040281). (ORPHA:3434)
- Orofacial cleft (HP:0000202): The presence of a cleft (gap, opening, or groove) in the oral cavity, including cleft of the upper lip and/or cleft of the palate. Cleft of the upper lip is visible as a groove or fissure in the lip, most frequently due to a congenital failure of the maxillary and median nasal processes to fuse. Cleft palate is characterized by a grooved depression or fissure in the roof of the mouth, most often resulting from a congenital failure of the palate to fuse properly. Clefts of the lip and palate can occur individually or together. It is preferable to code each defect separately. Evidence: TAS. Frequency: Very frequent (HP:0040281). (ORPHA:3434)
- Microcephaly (HP:0000252): Head circumference below 2 standard deviations below the mean for age and gender. Evidence: TAS. Frequency: Very frequent (HP:0040281). (ORPHA:3434)
- Mandibular prognathia (HP:0000303): Abnormal prominence of the chin related to increased length of the mandible. Evidence: TAS. Frequency: Very frequent (HP:0040281). (ORPHA:3434)
- Visual impairment (HP:0000505): Visual impairment (or vision impairment) is vision loss (of a person) to such a degree as to qualify as an additional support need through a significant limitation of visual capability resulting from either disease, trauma, or congenital or degenerative conditions that cannot be corrected by conventional means, such as refractive correction, medication, or surgery. Evidence: TAS. Frequency: Frequent (HP:0040282). (ORPHA:3434)
- Microphthalmia (HP:0000568): A developmental anomaly characterized by abnormal smallness of one or both eyes. Evidence: TAS. Frequency: Very frequent (HP:0040281). (ORPHA:3434)
- Triphalangeal thumb (HP:0001199): A thumb with three phalanges in a single, proximo-distal axis. Thus, this term applies if the thumb has an accessory phalanx, leading to a digit like appearance of the thumb. Evidence: TAS. Frequency: Frequent (HP:0040282). (ORPHA:3434)
- Intellectual disability (HP:0001249): The term intellectual disability or intellectual developmental disorder is used to describe significantly sub-average intellectual and adaptive functioning based on clinical assessment and as measured by individually administered, appropriately normed, standardized and validated tests of intellectual functioning and adaptive behavior, with onset during the developmental period from infancy through adolescence. Evidence: TAS. Frequency: Very frequent (HP:0040281). (ORPHA:3434)
- Ventricular septal defect (HP:0001629): A hole between the two bottom chambers (ventricles) of the heart. The defect is centered around the most superior aspect of the ventricular septum. Evidence: TAS. Frequency: Occasional (HP:0040283). (ORPHA:3434)
- Split foot (HP:0001839): A condition in which middle parts of the foot (toes and metatarsals) are missing giving a cleft appearance. The severity is very variable ranging from slightly hypoplastic 3rd toe over absent 2nd or 3rd toes as far as oligo- or monodactyl feet. Evidence: TAS. Frequency: Very frequent (HP:0040281). (ORPHA:3434)